Phenotypes associated with the disease spinocerebellar ataxia type 5 (OMIM:600224):
- Poor head control (HP:0002421): Difficulty to maintain correct position of the head while standing or sitting. Infant head lag is observed when the head seems to flop around or lags posteriorly behind the trunk. Several articles have maintained that head lag should be absent by age 3 to 4 months. Evidence: PCS. Frequency: 1/1. (PMID:22914369)
- Gaze-evoked nystagmus (HP:0000640): Nystagmus made apparent by looking to the right or to the left. Evidence: TAS. (OMIM:600224)
- Strabismus (HP:0000486): A misalignment of the eyes so that the visual axes deviate from bifoveal fixation. The classification of strabismus may be based on a number of features including the relative position of the eyes, whether the deviation is latent or manifest, intermittent or constant, concomitant or otherwise and according to the age of onset and the relevance of any associated refractive error. Evidence: PCS. Frequency: 1/1. (PMID:22914369)
- Dysmetria (HP:0001310): A type of ataxia characterized by the inability to carry out movements with the correct range and motion across the plane of more than one joint related to incorrect estimation of the distances required for targeted movements. Evidence: PCS. Frequency: 1/1. (PMID:22914369)
- Cerebellar atrophy (HP:0001272): Cerebellar atrophy is defined as a cerebellum with initially normal structures, in a posterior fossa with normal size, which displays enlarged fissures (interfolial spaces) in comparison to the foliae secondary to loss of tissue. Cerebellar atrophy implies irreversible loss of tissue and result from an ongoing progressive disease until a final stage is reached or a single injury, e.g. an intoxication or infectious event. Evidence: PCS. Frequency: 1/1. (PMID:22914369)
- Gait ataxia (HP:0002066): A type of ataxia characterized by the impairment of the ability to coordinate the movements required for normal walking. Gait ataxia is characteirzed by a wide-based staggering gait with a tendency to fall. Evidence: IEA. (OMIM:600224)
- Hypotonia (HP:0001252): Hypotonia is an abnormally low muscle tone (the amount of tension or resistance to movement in a muscle). Even when relaxed, muscles have a continuous and passive partial contraction which provides some resistance to passive stretching. Hypotonia thus manifests as diminished resistance to passive stretching. Hypotonia is not the same as muscle weakness, although the two conditions can co-exist. Evidence: PCS. Frequency: 1/1. (PMID:22914369)
- Ataxia (HP:0001251): Ataxia refers to impaired coordination of voluntary muscle movement. Cerebellar ataxia refers to ataxia due to dysfunction of the cerebellum. This causes a variety of elementary neurological deficits including asynergy (lack of coordination between muscles, limbs and joints), dysmetria (lack of ability to judge distances that can lead to under- or overshoot in grasping movements), and dysdiadochokinesia (inability to perform rapid movements requiring antagonizing muscle groups to be switched on and off repeatedly). Evidence: PCS. Frequency: 1/1. (PMID:22914369)
- Infantile onset (HP:0003593): Onset of signs or symptoms of disease between 28 days to one year of life. Evidence: PCS. Frequency: 1/1. (PMID:22914369)
- Intention tremor (HP:0002080): A type of kinetic tremor that occurs during target directed movement is called intention tremor. That is, an oscillatory cerebellar ataxia that tends to be absent when the limbs are inactive and during the first part of voluntary movement but worsening as the movement continues and greater precision is required (e.g., in touching a target such as the patient's nose or a physician's finger). Evidence: PCS. Frequency: 1/1. (PMID:22914369)
- Cognitive impairment (HP:0100543): Abnormal cognition is characterized by deficits in thinking, reasoning, or remembering. Evidence: TAS. (OMIM:600224)
- Horizontal jerk nystagmus (HP:0007286): Nystagmus consisting of horizontal to-and-fro eye movements, in which the movement in one direction is faster than in the other. Evidence: PCS. Frequency: 1/1. (PMID:22914369)
- Facial myokymia (HP:0000317): Facial myokymia is a fine fibrillary activity of one or more muscles innervated by the facial nerve (the seventh cranial nerve). Evidence: PCS. Frequency: 1/1. (PMID:22914369)
- Hyperreflexia (HP:0001347): Hyperreflexia is the presence of hyperactive stretch reflexes of the muscles. Evidence: PCS. Frequency: 1/1. (PMID:22914369)
- Incoordination (HP:0002311): A deficit in coordination of muscle movements. Coordination is defined as the orchestrated movement of multiple body parts as required to accomplish intended actions, like walking. Evidence: IEA. (OMIM:600224)
- Broad-based gait (HP:0002136): An abnormal gait pattern in which persons stand and walk with their feet spaced widely apart. This is often a component of cerebellar ataxia. Evidence: PCS. Frequency: 1/1. (PMID:22914369)
- Rotary nystagmus (HP:0001583): A form of nystagmus in which the eyeball makes rotary motions around the axis. Evidence: PCS. Frequency: 1/1. (PMID:22914369)
- Cerebellar hypoplasia (HP:0001321): Cerebellar hypoplasia is a descriptive term implying a cerebellum with a reduced volume, but a normal shape and is stable over time. Evidence: PCS. Frequency: 1/1. (PMID:22914369)
- Dysarthria (HP:0001260): Dysarthric speech is a general description referring to a neurological speech disorder characterized by poor articulation. Depending on the involved neurological structures, dysarthria may be further classified as spastic, flaccid, ataxic, hyperkinetic and hypokinetic, or mixed. Evidence: PCS. Frequency: 1/1. (PMID:22914369)
- Impaired vibratory sensation (HP:0002495): A decrease in the ability to perceive vibration. Clinically, this is usually tested with a tuning fork which vibrates at 128 Hz and is applied to bony prominences such as the malleoli at the ankles or the metacarpal-phalangeal joints. There is a slow decay of vibration from the tuning fork. The degree of vibratory sense loss can be crudely estimated by counting the number of seconds that the examiner can perceive the vibration longer than the patient. Evidence: IEA. (OMIM:600224)
- Global developmental delay (HP:0001263): A delay in the achievement of motor or mental milestones in the domains of development of a child, including motor skills, speech and language, cognitive skills, and social and emotional skills. This term should only be used to describe children younger than five years of age. Evidence: PCS. Frequency: 1/1. (PMID:22914369)
- Dysdiadochokinesis (HP:0002075): A type of ataxia characterized by the impairment of the ability to perform rapidly alternating movements, such as pronating and supinating his or her hand on the dorsum of the other hand as rapidly as possible. Evidence: PCS. Frequency: 1/1. (PMID:22914369)
- Upper motor neuron dysfunction (HP:0002493): A functional anomaly of the upper motor neuron. The upper motor neurons are neurons of the primary motor cortex which project to the brainstem and spinal chord via the corticonuclear, corticobulbar and corticospinal (pyramidal) tracts. They are involved in control of voluntary movements. Dysfunction leads to weakness, impairment of fine motor movements, spasticity, hyperreflexia and abnormal pyramidal signs. Evidence: IEA. (OMIM:600224)
- Limb ataxia (HP:0002070): A kind of ataxia that affects movements of the extremities. Evidence: IEA. (OMIM:600224)
- Ankle clonus (HP:0011448): Clonus is an involuntary tendon reflex that causes repeated flexion and extension of the foot. Ankle clonus is tested by rapidly flexing the foot upward. Evidence: PCS. Frequency: 1/1. (PMID:22914369)
- Impaired smooth pursuit (HP:0007772): An impairment of the ability to track objects with the ocular smooth pursuit system, a class of rather slow eye movements that minimizes retinal target motion. Evidence: IEA. (OMIM:600224)
- Autosomal dominant inheritance (HP:0000006): A mode of inheritance that is observed for traits related to a gene encoded on one of the autosomes (i.e., the human chromosomes 1-22) in which a trait manifests in heterozygotes. In the context of medical genetics, an autosomal dominant disorder is caused when a single copy of the mutant allele is present. Males and females are affected equally, and can both transmit the disorder with a risk of 50% for each child of inheriting the mutant allele. Evidence: PCS. (PMID:16429157)
- Slowly progressive (HP:0003677): Applies to a disease manifestation that only slowly increases in scope or severity over the course of time. Evidence: PCS. Frequency: 1/1. (PMID:22914369)